- Giant hypertrophic gastritis (HP:0005246): A type of gastritis characterized by excessive proliferation of the gastric mucosa and diffuse thickening of the gastric mucosal folds. Evidence: IEA. (OMIM:137280)
- Hypoproteinemia (HP:0003075): A decreased concentration of protein in the blood. Evidence: IEA. (OMIM:137280)
- Autosomal recessive inheritance (HP:0000007): A mode of inheritance that is observed for traits related to a gene encoded on one of the autosomes (i.e., the human chromosomes 1-22) in which a trait manifests in individuals with two pathogenic alleles, either homozygotes (two copies of the same mutant allele) or compound heterozygotes (whereby each copy of a gene has a distinct mutant allele). Evidence: TAS. (OMIM:137280)
- Vascular dilatation (HP:0002617): An abnormal increase in the diameter of an artery or vein, either as a diffuse dilatation or as a localized, sac-like outpouching of the vessel wall (aneurysm). Evidence: IEA. (OMIM:137280)
These phenotypes are associated with the disease gastric mucosal hypertrophy (OMIM:137280).